- Helicobacter pylori infection (HP:0005202): A recurrent infection of the GI tract with helicobacter pylori, a gram-negative, microaerophilic bacterium usually found in the stomach. Evidence: IEA. (OMIM:600263)
This phenotype is associated with the disease Helicobacter pylori infection, susceptibility to (OMIM:600263).